Phenotypes associated with the disease encephalopathy, acute, infection-induced (herpes-specific), susceptibility to, 8 (OMIM:617900):
- Lethargy (HP:0001254): A state of fatigue, either physical or mental slowness and sluggishness, with difficulties in initiating or performing simple tasks. Distinguished from apathy which implies indifference and a lack of desire or interest in the task. A person with lethargy may have the desire, but not the energy to engage in personal or socially relevant tasks. Evidence: IEA. (OMIM:617900)
- Meningitis (HP:0001287): Inflammation of the meninges. Evidence: IEA. (OMIM:617900)
- Juvenile onset (HP:0003621): Onset of signs or symptoms of disease between the age of 5 and 15 years. Evidence: PCS. Frequency: 1/2. (PMID:22851595)
- Confusion (HP:0001289): Lack of clarity and coherence of thought, perception, understanding, or action. Evidence: IEA. (OMIM:617900)
- EEG abnormality (HP:0002353): Abnormality observed by electroencephalogram (EEG), which is used to record of the brain's spontaneous electrical activity from multiple electrodes placed on the scalp. Evidence: IEA. (OMIM:617900)
- Middle age onset (HP:0003596): A type of adult onset with onset of symptoms at the age of 40 to 60 years. Evidence: PCS. Frequency: 1/1. (PMID:26513235)
- Seizure (HP:0001250): A seizure is an intermittent abnormality of nervous system physiology characterized by a transient occurrence of signs and/or symptoms due to abnormal excessive or synchronous neuronal activity in the brain. Evidence: IEA. (OMIM:617900)
- Infantile onset (HP:0003593): Onset of signs or symptoms of disease between 28 days to one year of life. Evidence: IEA. Frequency: 1/2. (PMID:22851595)
- HSV encephalitis (HP:0012302): Infection of the brain parenchyma with herpes simplex virus, resulting in inflammation of the brain parenchyma with neurologic dysfunction. Evidence: PCS. Frequency: 3/3. (PMID:22851595;PMID:26513235)
- Typified by incomplete penetrance (HP:0003829): Description of conditions in which not all individuals with a given genotype exhibit the disease. Penetrance is the proportion that develop disease given a lifespan of 80 years. Evidence: IEA. (OMIM:617900)
- Hemiparesis (HP:0001269): Loss of strength in the arm, leg, and sometimes face on one side of the body. Hemiplegia refers to a complete loss of strength, whereas hemiparesis refers to an incomplete loss of strength. Evidence: IEA. (OMIM:617900)
- Mental deterioration (HP:0001268): Loss of previously present mental abilities, generally in adults. Evidence: IEA. (OMIM:617900)
- Autosomal dominant inheritance (HP:0000006): A mode of inheritance that is observed for traits related to a gene encoded on one of the autosomes (i.e., the human chromosomes 1-22) in which a trait manifests in heterozygotes. In the context of medical genetics, an autosomal dominant disorder is caused when a single copy of the mutant allele is present. Males and females are affected equally, and can both transmit the disorder with a risk of 50% for each child of inheriting the mutant allele. Evidence: PCS. (PMID:22851595)